- Hyperextensibility of the finger joints (HP:0001187): The ability of the finger joints to move beyond their normal range of motion. Evidence: TAS. (OMIM:105835)
- Short stature (HP:0004322): A height below that which is expected according to age and gender norms. Although there is no universally accepted definition of short stature, many refer to "short stature" as height more than 2 standard deviations below the mean for age and gender (or below the 3rd percentile for age and gender dependent norms). Evidence: TAS. (OMIM:105835)
- Premature osteoarthritis (HP:0003088). Evidence: TAS. (OMIM:105835)
- Hip osteoarthritis (HP:0008843). Evidence: TAS. (OMIM:105835)
- Delayed ossification of carpal bones (HP:0001216): Ossification of carpal bones occurs later than age-adjusted norms. Evidence: TAS. (OMIM:105835)
- Metacarpal pseudoepiphysis (HP:0009193): A pseudoepiphysis is a secondary ossification center distinct from the normal epiphysis. The normal metacarpal epiphyses are located at the distal ends of the metacarpal bones. Accessory epiphyses (which are also known as pseudoepiphyses) can also occasionally be observed at the proximal ends of the metacarpals, usually involving the 2nd metacarpal bone. Evidence: TAS. (OMIM:105835)
These phenotypes are associated with the disease Angel-shaped phalango-epiphyseal dysplasia (OMIM:105835).